Phenotypes associated with the disease Leishmaniasis (ORPHA:507):
- Abnormal oral cavity morphology (HP:0000163): Abnormality of the oral cavity, i.e., the opening or hollow part of the mouth. Evidence: TAS. Frequency: Very frequent (HP:0040281). (ORPHA:507)
- Splenomegaly (HP:0001744): Abnormal increased size of the spleen. Evidence: TAS. Frequency: Very frequent (HP:0040281). (ORPHA:507)
- Pancytopenia (HP:0001876): An abnormal reduction in numbers of all blood cell types (red blood cells, white blood cells, and platelets). Evidence: TAS. Frequency: Very frequent (HP:0040281). (ORPHA:507)
- Abnormal bleeding (HP:0001892): An abnormal susceptibility to bleeding, often referred to as a bleeding diathesis. A bleeding diathesis may be related to vascular, platelet and coagulation defects. Evidence: TAS. Frequency: Very frequent (HP:0040281). (ORPHA:507)
- Recurrent fever (HP:0001954): Periodic (episodic or recurrent) bouts of fever. Evidence: TAS. Frequency: Very frequent (HP:0040281). (ORPHA:507)
- Hepatomegaly (HP:0002240): Abnormally increased size of the liver. Evidence: TAS. Frequency: Very frequent (HP:0040281). (ORPHA:507)
- Lymphadenopathy (HP:0002716): Enlargement (swelling) of a lymph node. Evidence: TAS. Frequency: Very frequent (HP:0040281). (ORPHA:507)
- Abnormal macrophage morphology (HP:0004311): An abnormality of macrophages. Evidence: TAS. Frequency: Very frequent (HP:0040281). (ORPHA:507)
- Abnormal oral mucosa morphology (HP:0011830): Abnormality of the oral mucosa. Evidence: TAS. Frequency: Very frequent (HP:0040281). (ORPHA:507)
- Rhinitis (HP:0012384): Inflammation of the nasal mucosa with nasal congestion. Evidence: TAS. Frequency: Very frequent (HP:0040281). (ORPHA:507)
- Night sweats (HP:0030166): Occurrence of excessive sweating during sleep. Evidence: TAS. Frequency: Very frequent (HP:0040281). (ORPHA:507)
- Papule (HP:0200034): A circumscribed, solid elevation of skin with no visible fluid, varying in size from a pinhead to less than 10mm in diameter at the widest point. Evidence: TAS. Frequency: Very frequent (HP:0040281). (ORPHA:507)
- Skin plaque (HP:0200035): A plaque is a solid, raised, plateau-like (flat-topped) lesion greater than 1 cm in diameter. Evidence: TAS. Frequency: Very frequent (HP:0040281). (ORPHA:507)
- Skin ulcer (HP:0200042): A discontinuity of the skin exhibiting complete loss of the epidermis and often portions of the dermis and even subcutaneous fat. Evidence: TAS. Frequency: Very frequent (HP:0040281). (ORPHA:507)
- Pallor (HP:0000980): Abnormally pale skin. Evidence: TAS. Frequency: Frequent (HP:0040282). (ORPHA:507)
- Weight loss (HP:0001824): Reduction of total body weight. Evidence: TAS. Frequency: Frequent (HP:0040282). (ORPHA:507)
- Anemia (HP:0001903): A reduction in erythrocytes volume or hemoglobin concentration. Evidence: TAS. Frequency: Frequent (HP:0040282). (ORPHA:507)
- Arthralgia (HP:0002829): Joint pain. Evidence: TAS. Frequency: Frequent (HP:0040282). (ORPHA:507)
- Elevated circulating hepatic transaminase concentration (HP:0002910): Elevations of the levels of SGOT and SGPT in the serum. SGOT (serum glutamic oxaloacetic transaminase) and SGPT (serum glutamic pyruvic transaminase) are transaminases primarily found in the liver and heart and are released into the bloodstream as the result of liver or heart damage. SGOT and SGPT are used clinically mainly as markers of liver damage. Evidence: TAS. Frequency: Frequent (HP:0040282). (ORPHA:507)
- Hypoalbuminemia (HP:0003073): The concentration of albumin in the blood circulation is below the lower limit of normal. Evidence: TAS. Frequency: Frequent (HP:0040282). (ORPHA:507)
- Increased circulating immunoglobulin concentration (HP:0010702): An increased level of gamma globulin (immunoglobulin) in the blood. Evidence: TAS. Frequency: Frequent (HP:0040282). (ORPHA:507)
- Thrombocytopenia (HP:0001873): A reduction in the number of circulating thrombocytes. Evidence: TAS. Frequency: Occasional (HP:0040283). (ORPHA:507)
- Decreased total leukocyte count (HP:0001882): An abnormal decreased number of leukocytes in the blood. Evidence: TAS. Frequency: Occasional (HP:0040283). (ORPHA:507)
- Anorexia (HP:0002039): Lack of desire to eat (loss of appetite). Evidence: TAS. Frequency: Occasional (HP:0040283). (ORPHA:507)
- Fatigue (HP:0012378): A subjective feeling of tiredness characterized by a lack of energy and motivation. Evidence: TAS. Frequency: Occasional (HP:0040283). (ORPHA:507)